Phenotypes associated with the disease retinitis pigmentosa 60 (OMIM:613983):
- Constriction of peripheral visual field (HP:0001133): An absolute or relative decrease in retinal sensitivity extending from edge (periphery) of the visual field in a concentric pattern. The visual field is the area that is perceived simultaneously by a fixating eye. Evidence: PCS. Frequency: 2/2. (PMID:21549338)
- Spicular pigmentation of the retina (HP:0007737): Pigment migration into the retina in a bone-spicule configuration (resembling the nucleated cells within the lacuna of bone). Evidence: PCS. Frequency: 1/1. (PMID:21549338)
- Nyctalopia (HP:0000662): Inability to see well at night or in poor light. Evidence: PCS. Frequency: 2/2. (PMID:21549338)
- Young adult onset (HP:0011462): Onset of disease at the age of between 16 and 40 years. Evidence: PCS. Frequency: 2/2. (PMID:21549338)
- Reduced visual acuity (HP:0007663). Evidence: PCS. Frequency: 2/2. (PMID:21549338)
- Visual impairment (HP:0000505): Visual impairment (or vision impairment) is vision loss (of a person) to such a degree as to qualify as an additional support need through a significant limitation of visual capability resulting from either disease, trauma, or congenital or degenerative conditions that cannot be corrected by conventional means, such as refractive correction, medication, or surgery. Evidence: PCS. Frequency: 2/2. (PMID:21549338)
- Peripheral visual field loss (HP:0007994): Loss of peripheral vision with retention of central vision, resulting in a constricted circular tunnel-like field of vision. Evidence: PCS. Frequency: 2/2. (PMID:21549338)
- Rod-cone dystrophy (HP:0000510): An inherited retinal disease subtype in which the rod photoreceptors appear to be more severely affected than the cone photoreceptors. Typical presentation is with nyctalopia (due to rod dysfunction) followed by loss of mid-peripheral field of vision, which gradually extends and leaves many patients with a small central island of vision due to the preservation of macular cones. Evidence: PCS. Frequency: 2/2. (PMID:21549338)
- Posterior subcapsular cataract (HP:0007787): A type of cataract affecting the posterior pole of lens immediately adjacent to ('beneath') the Lens capsule. Evidence: PCS. Frequency: 1/2. (PMID:21549338)
- Optic disc pallor (HP:0000543): A pale yellow discoloration of the optic disc (the area of the optic nerve head in the retina). The optic disc normally has a pinkish hue with a central yellowish depression. Evidence: PCS. Frequency: 1/2. (PMID:21549338)
- Retinal pigment epithelial atrophy (HP:0007722): A nonspecific term denoting wasting, especially as a result of degeneration, of the retinal pigment epithelium (RPE). Evidence: PCS. Frequency: 1/1. (PMID:21549338)
- Attenuation of retinal blood vessels (HP:0007843): Narrowing of the retinal blood vessels, both arterioles and venules. Evidence: PCS. Frequency: 1/1. (PMID:21549338)
- Autosomal dominant inheritance (HP:0000006): A mode of inheritance that is observed for traits related to a gene encoded on one of the autosomes (i.e., the human chromosomes 1-22) in which a trait manifests in heterozygotes. In the context of medical genetics, an autosomal dominant disorder is caused when a single copy of the mutant allele is present. Males and females are affected equally, and can both transmit the disorder with a risk of 50% for each child of inheriting the mutant allele. Evidence: PCS. (PMID:21549338)